Phenotypes associated with the disease vesicoureteral reflux 2 (OMIM:610878, an entry in Online Mendelian Inheritance in Man):
- Vesicoureteral reflux (HP:0000076, a Human Phenotype Ontology term): Abnormal (retrograde) movement of urine from the bladder into ureters or kidneys related to inadequacy of the valvular mechanism at the ureterovesicular junction or other causes. Evidence: PCS. (PMID:17357069)
- Renal hypoplasia (HP:0000089, a Human Phenotype Ontology term): Hypoplasia of the kidney. Evidence: PCS. (PMID:17357069)
- Autosomal dominant inheritance (HP:0000006, a Human Phenotype Ontology term): A mode of inheritance that is observed for traits related to a gene encoded on one of the autosomes (i.e., the human chromosomes 1-22) in which a trait manifests in heterozygotes. In the context of medical genetics, an autosomal dominant disorder is caused when a single copy of the mutant allele is present. Males and females are affected equally, and can both transmit the disorder with a risk of 50% for each child of inheriting the mutant allele. Evidence: PCS. (PMID:17357069)